Phenotypes associated with the disease Ankyloblepharon filiforme adnatum-imperforate anus syndrome (ORPHA:1074):
- Cryptorchidism (HP:0000028): Testis in inguinal canal. That is, absence of one or both testes from the scrotum owing to failure of the testis or testes to descend through the inguinal canal to the scrotum. Evidence: TAS. Frequency: Very frequent (HP:0040281). (ORPHA:1074)
- Cleft palate (HP:0000175): Cleft palate is a developmental defect of the palate resulting from a failure of fusion of the palatine processes and manifesting as a separation of the roof of the mouth (soft and hard palate). Evidence: TAS. Frequency: Occasional (HP:0040283). (ORPHA:1074)
- Ankyloblepharon (HP:0009755): Partial fusion of the upper and lower eyelid margins by single or multiple bands of tissue. Evidence: TAS. Frequency: Very frequent (HP:0040281). (ORPHA:1074)
- Tooth agenesis (HP:0009804): The absence of one or more teeth from the normal series by a failure to develop. Evidence: TAS. Frequency: Frequent (HP:0040282). (ORPHA:1074)
- Non-midline cleft of the upper lip (HP:0100335): Clefting (gap or groove) of the upper lip affecting the lateral portions of the upper lip rather than the midline/median region. Evidence: TAS. Frequency: Occasional (HP:0040283). (ORPHA:1074)